Phenotypes associated with the disease Acrofacial dysostosis, Weyers type (ORPHA:952):
- Abnormality of the dentition (HP:0000164): Any abnormality of the teeth. Evidence: TAS. Frequency: Very frequent (HP:0040281). (ORPHA:952)
- Abnormal oral frenulum morphology (HP:0000190): An abnormality of the lingual frenulum, that is of the small fold of mucous membrane that attaches the tongue to the floor of the mouth, or the presence of accessory frenula in the oral cavity. Evidence: TAS. Frequency: Very frequent (HP:0040281). (ORPHA:952)
- Hypodontia (HP:0000668): The absence of five or less teeth from the normal series by a failure to develop. Evidence: TAS. Frequency: Very frequent (HP:0040281). (ORPHA:952)
- Conical tooth (HP:0000698): An abnormal conical form of the teeth, that is, a tooth whose sides converge or taper together incisally. Evidence: TAS. Frequency: Very frequent (HP:0040281). (ORPHA:952)
- Postaxial hand polydactyly (HP:0001162): Supernumerary digits located at the ulnar side of the hand (that is, on the side with the fifth finger). Evidence: TAS. Frequency: Very frequent (HP:0040281). (ORPHA:952)
- Abnormal fingernail morphology (HP:0001231): An abnormality of the fingernails. Evidence: TAS. Frequency: Very frequent (HP:0040281). (ORPHA:952)
- Small nail (HP:0001792): A nail that is diminished in length and width, i.e., underdeveloped nail. Evidence: TAS. Frequency: Very frequent (HP:0040281). (ORPHA:952)
- Hypoplastic toenails (HP:0001800): Underdevelopment of the toenail. Evidence: TAS. Frequency: Very frequent (HP:0040281). (ORPHA:952)
- Tessier cleft (HP:0002006): A congenital malformation with a cleft (gap or opening) in the face. Evidence: TAS. Frequency: Frequent (HP:0040282). (ORPHA:952)
- Mild short stature (HP:0003502): A mild degree of short stature, more than -2 SD but not more than -3 SD from mean corrected for age and sex. Evidence: TAS. Frequency: Very frequent (HP:0040281). (ORPHA:952)
- Clinodactyly of the 5th finger (HP:0004209): Clinodactyly refers to a bending or curvature of the fifth finger in the radial direction (i.e., towards the 4th finger). Evidence: TAS. Frequency: Frequent (HP:0040282). (ORPHA:952)
- Advanced eruption of teeth (HP:0006288): Premature tooth eruption, which can be defined as tooth eruption more than 2 SD earlier than the mean eruption age. Evidence: TAS. Frequency: Very frequent (HP:0040281). (ORPHA:952)
- Solitary median maxillary central incisor (HP:0006315): A single maxillary central incisor positioned in the midline with morphological symmetry of the crown and bordered by lateral incisors. Evidence: TAS. Frequency: Very frequent (HP:0040281). (ORPHA:952)
- Abnormal toenail morphology (HP:0008388): An anomaly of the toenail. Evidence: TAS. Frequency: Very frequent (HP:0040281). (ORPHA:952)
- Nail dystrophy (HP:0008404): Onychodystrophy (nail dystrophy) refers to nail changes apart from changes of the color (nail dyschromia) and involves partial or complete disruption of the various keratinous layers of the nail plate. Evidence: TAS. Frequency: Very frequent (HP:0040281). (ORPHA:952)
- Abnormal antihelix morphology (HP:0009738): An abnormality of the antihelix. Evidence: TAS. Frequency: Frequent (HP:0040282). (ORPHA:952)
- Overlapping fingers (HP:0010557): A finger resting on the dorsal surface of an adjacent digit when the hand is at rest. Evidence: TAS. Frequency: Frequent (HP:0040282). (ORPHA:952)
- Toenail dysplasia (HP:0100797): An abnormality of the development of the toenails. Evidence: TAS. Frequency: Very frequent (HP:0040281). (ORPHA:952)
- Small hand (HP:0200055): Disproportionately small hand. Evidence: TAS. Frequency: Frequent (HP:0040282). (ORPHA:952)